Phenotypes associated with the disease DERMAL RIDGES-OFF-THE-END (OMIM:125550):
- Abnormal palmar dermal ridges (HP:0007608). Evidence: TAS. (OMIM:125550)
- Autosomal dominant inheritance (HP:0000006): A mode of inheritance that is observed for traits related to a gene encoded on one of the autosomes (i.e., the human chromosomes 1-22) in which a trait manifests in heterozygotes. In the context of medical genetics, an autosomal dominant disorder is caused when a single copy of the mutant allele is present. Males and females are affected equally, and can both transmit the disorder with a risk of 50% for each child of inheriting the mutant allele. Evidence: TAS. (OMIM:125550)